- Hypoplasia of the corpus callosum (HP:0002079): Underdevelopment of the corpus callosum. Evidence: TAS. Frequency: Very frequent (HP:0040281). (ORPHA:306511)
- Progressive spastic paraplegia (HP:0007020). Evidence: TAS. Frequency: Very frequent (HP:0040281). (ORPHA:306511)
- Urinary incontinence (HP:0000020): Loss of the ability to control the urinary bladder leading to involuntary urination. Evidence: TAS. Frequency: Frequent (HP:0040282). (ORPHA:306511)
- Intellectual disability (HP:0001249): The term intellectual disability or intellectual developmental disorder is used to describe significantly sub-average intellectual and adaptive functioning based on clinical assessment and as measured by individually administered, appropriately normed, standardized and validated tests of intellectual functioning and adaptive behavior, with onset during the developmental period from infancy through adolescence. Evidence: TAS. Frequency: Frequent (HP:0040282). (ORPHA:306511)
- Ataxia (HP:0001251): Ataxia refers to impaired coordination of voluntary muscle movement. Cerebellar ataxia refers to ataxia due to dysfunction of the cerebellum. This causes a variety of elementary neurological deficits including asynergy (lack of coordination between muscles, limbs and joints), dysmetria (lack of ability to judge distances that can lead to under- or overshoot in grasping movements), and dysdiadochokinesia (inability to perform rapid movements requiring antagonizing muscle groups to be switched on and off repeatedly). Evidence: TAS. Frequency: Frequent (HP:0040282). (ORPHA:306511)
- Myoclonus (HP:0001336): Very brief, involuntary random muscular contractions occurring at rest, in response to sensory stimuli, or accompanying voluntary movements. Evidence: TAS. Frequency: Frequent (HP:0040282). (ORPHA:306511)
- Hyperreflexia (HP:0001347): Hyperreflexia is the presence of hyperactive stretch reflexes of the muscles. Evidence: TAS. Frequency: Frequent (HP:0040282). (ORPHA:306511)
- Lower limb spasticity (HP:0002061): Spasticity (velocity-dependent increase in tonic stretch reflexes with increased muscle tone and hyperexcitable tendon reflexes) in the muscles of the lower limbs, hips, and pelvis. Evidence: TAS. Frequency: Frequent (HP:0040282). (ORPHA:306511)
- Spastic gait (HP:0002064): Spasticity is manifested by increased stretch reflex which is intensified with movement velocity. This results in excessive and inappropriate muscle activation which can contribute to muscle hypertonia. Spastic gait is characterized by manifestations such as muscle hypertonia, stiff knee, and circumduction of the leg. Evidence: TAS. Frequency: Frequent (HP:0040282). (ORPHA:306511)
- Urinary bladder sphincter dysfunction (HP:0002839): Abnormal function of a sphincter of the urinary bladder. Evidence: TAS. Frequency: Frequent (HP:0040282). (ORPHA:306511)
- Elevated circulating creatine kinase activity (HP:0003236): The activity of creatine kinase in the blood circulation is above the upper limit of normal. Evidence: TAS. Frequency: Frequent (HP:0040282). (ORPHA:306511)
- Abnormality of the cervical spine (HP:0003319): Any abnormality of the cervical vertebral column. Evidence: TAS. Frequency: Frequent (HP:0040282). (ORPHA:306511)
- Lower limb muscle weakness (HP:0007340): Weakness of the muscles of the legs. Evidence: TAS. Frequency: Frequent (HP:0040282). (ORPHA:306511)
- Hyperintensity of cerebral white matter on MRI (HP:0030890): A brighter than expected signal on magnetic resonance imaging emanating from the cerebral white matter. Evidence: TAS. Frequency: Frequent (HP:0040282). (ORPHA:306511)
- Cognitive impairment (HP:0100543): Abnormal cognition is characterized by deficits in thinking, reasoning, or remembering. Evidence: TAS. Frequency: Frequent (HP:0040282). (ORPHA:306511)
- Retinopathy (HP:0000488): Any noninflammatory disease of the retina. This nonspecific term is retained here because of its wide use in the literature, but if possible new annotations should indicate the precise type of retinal abnormality. Evidence: TAS. Frequency: Occasional (HP:0040283). (ORPHA:306511)
- Parkinsonism (HP:0001300): Characteristic neurologic anomaly resulting from degeneration of dopamine-generating cells in the substantia nigra, a region of the midbrain, characterized clinically by shaking, rigidity, slowness of movement and difficulty with walking and gait. Evidence: TAS. Frequency: Occasional (HP:0040283). (ORPHA:306511)
- Broad-based gait (HP:0002136): An abnormal gait pattern in which persons stand and walk with their feet spaced widely apart. This is often a component of cerebellar ataxia. Evidence: TAS. Frequency: Occasional (HP:0040283). (ORPHA:306511)
- Peripheral neuropathy (HP:0009830): Peripheral neuropathy is a general term for any disorder of the peripheral nervous system. The main clinical features used to classify peripheral neuropathy are distribution, type (mainly demyelinating versus mainly axonal), duration, and course. Evidence: TAS. Frequency: Occasional (HP:0040283). (ORPHA:306511)
These phenotypes are associated with the disease Autosomal recessive spastic paraplegia type 48 (ORPHA:306511).